- Horner syndrome (HP:0002277): An abnormality resulting from a lesion of the sympathetic nervous system characterized by a combination of unilateral ptosis, miosis, and often ipsilateral hypohidrosis and conjunctival injection. Evidence: IEA. (OMIM:106070)
- Hematuria (HP:0000790): The presence of blood in the urine. Hematuria may be gross hematuria (visible to the naked eye) or microscopic hematuria (detected by dipstick or microscopic examination of the urine). Evidence: IEA. (OMIM:106070)
- Hemiparesis (HP:0001269): Loss of strength in the arm, leg, and sometimes face on one side of the body. Hemiplegia refers to a complete loss of strength, whereas hemiparesis refers to an incomplete loss of strength. Evidence: IEA. (OMIM:106070)
- Gastrointestinal hemorrhage (HP:0002239): Hemorrhage affecting the gastrointestinal tract. Evidence: IEA. (OMIM:106070)
- Autosomal dominant inheritance (HP:0000006): A mode of inheritance that is observed for traits related to a gene encoded on one of the autosomes (i.e., the human chromosomes 1-22) in which a trait manifests in heterozygotes. In the context of medical genetics, an autosomal dominant disorder is caused when a single copy of the mutant allele is present. Males and females are affected equally, and can both transmit the disorder with a risk of 50% for each child of inheriting the mutant allele. Evidence: IEA. (OMIM:106070)
- Hemangioma (HP:0001028): A hemangioma is a benign tumor characterized by blood-filled spaces lined by benign endothelial cells. A hemangioma characterized by large endothelial spaces (caverns) is called a cavernous hemangioma (in contrast to a hemangioma with small endothelial spaces, which is called capillary hemangioma). Evidence: IEA. (OMIM:106070)
These phenotypes are associated with the disease hereditary neurocutaneous angioma (OMIM:106070).